- Long eyebrows (HP:0004523): Increased length of the hairs of the eyebrows. Evidence: TAS. Frequency: Occasional (HP:0040283). (OMIM:201180)
- S-shaped palpebral fissures (HP:0007835). Evidence: TAS. Frequency: Occasional (HP:0040283). (OMIM:201180)
- Small nail (HP:0001792): A nail that is diminished in length and width, i.e., underdeveloped nail. Evidence: TAS. (OMIM:201180)
- Short stature (HP:0004322): A height below that which is expected according to age and gender norms. Although there is no universally accepted definition of short stature, many refer to "short stature" as height more than 2 standard deviations below the mean for age and gender (or below the 3rd percentile for age and gender dependent norms). Evidence: TAS. Frequency: Obligate (HP:0040280). (OMIM:201180)
- Seizure (HP:0001250): A seizure is an intermittent abnormality of nervous system physiology characterized by a transient occurrence of signs and/or symptoms due to abnormal excessive or synchronous neuronal activity in the brain. Evidence: TAS. Frequency: Occasional (HP:0040283). (OMIM:201180)
- Acetabular dysplasia (HP:0008807): A smaller than normal acetabulum that has insufficient femoral head coverage leading to abnormal hip joint contact pressures, instability and pain. Evidence: TAS. (OMIM:201180)
- Short metacarpal (HP:0010049): Diminished length of one or more metacarpal bones in relation to the others of the same hand or to the contralateral metacarpal. Evidence: TAS. (OMIM:201180)
- Short distal phalanx of finger (HP:0009882): Short distance from the end of the finger to the most distal interphalangeal crease or the distal interphalangeal joint flexion point. That is, hypoplasia of one or more of the distal phalanx of finger. Evidence: TAS. (OMIM:201180)
- Hypertelorism (HP:0000316): Interpupillary distance more than 2 SD above the mean (alternatively, the appearance of an increased interpupillary distance or widely spaced eyes). Evidence: TAS. Frequency: Obligate (HP:0040280). (OMIM:201180)
- Broad forehead (HP:0000337): Width of the forehead or distance between the frontotemporales is more than two standard deviations above the mean (objective); or apparently increased distance between the two sides of the forehead. Evidence: TAS. (OMIM:201180)
- Mixed hearing impairment (HP:0000410): A type of hearing loss resulting from a combination of conductive hearing impairment and sensorineural hearing impairment. Evidence: TAS. Frequency: Occasional (HP:0040283). (OMIM:201180)
- Oligodontia (HP:0000677): The absence of six or more teeth from the normal series by a failure to develop. Evidence: TAS. Frequency: Occasional (HP:0040283). (OMIM:201180)
- Intellectual disability (HP:0001249): The term intellectual disability or intellectual developmental disorder is used to describe significantly sub-average intellectual and adaptive functioning based on clinical assessment and as measured by individually administered, appropriately normed, standardized and validated tests of intellectual functioning and adaptive behavior, with onset during the developmental period from infancy through adolescence. Evidence: TAS. Frequency: Obligate (HP:0040280). (OMIM:201180)
- Iris atrophy (HP:0001089): Loss of iris tissue (atrophy). Evidence: TAS. Frequency: Occasional (HP:0040283). (OMIM:201180)
- Wide mouth (HP:0000154): Distance between the oral commissures more than 2 SD above the mean. Alternatively, an apparently increased width of the oral aperture (subjective). Evidence: TAS. (OMIM:201180)
- Cleft palate (HP:0000175): Cleft palate is a developmental defect of the palate resulting from a failure of fusion of the palatine processes and manifesting as a separation of the roof of the mouth (soft and hard palate). Evidence: TAS. (OMIM:201180)
- Wide nasal bridge (HP:0000431): Increased breadth of the nasal bridge (and with it, the nasal root). Evidence: TAS. (OMIM:201180)
- Malar flattening (HP:0000272): Underdevelopment of the malar prominence of the jugal bone (zygomatic bone in mammals), appreciated in profile, frontal view, and/or by palpation. Evidence: TAS. (OMIM:201180)
- Broad thumb (HP:0011304): Increased thumb width without increased dorso-ventral dimension. Evidence: TAS. Frequency: Occasional (HP:0040283). (OMIM:201180)
- Ptosis (HP:0000508): The upper eyelid margin is positioned 3 mm or more lower than usual and covers the superior portion of the iris (objective); or, the upper lid margin obscures at least part of the pupil (subjective). Evidence: TAS. (OMIM:201180)
- Pectus excavatum (HP:0000767): A defect of the chest wall characterized by a depression of the sternum, giving the chest ("pectus") a caved-in ("excavatum") appearance. Evidence: TAS. Frequency: Occasional (HP:0040283). (OMIM:201180)
- Widow's peak (HP:0000349): Frontal hairline with bilateral arcs to a low point in the midline of the forehead. Evidence: TAS. Frequency: Occasional (HP:0040283). (OMIM:201180)
- Microphthalmia (HP:0000568): A developmental anomaly characterized by abnormal smallness of one or both eyes. Evidence: TAS. Frequency: Occasional (HP:0040283). (OMIM:201180)
- Autosomal recessive inheritance (HP:0000007): A mode of inheritance that is observed for traits related to a gene encoded on one of the autosomes (i.e., the human chromosomes 1-22) in which a trait manifests in individuals with two pathogenic alleles, either homozygotes (two copies of the same mutant allele) or compound heterozygotes (whereby each copy of a gene has a distinct mutant allele). Evidence: TAS. (OMIM:201180)
- Long eyelashes (HP:0000527): Mid upper eyelash length >10 mm or increased length of the eyelashes (subjective). Evidence: TAS. Frequency: Occasional (HP:0040283). (OMIM:201180)
- Optic atrophy (HP:0000648): Atrophy of the optic nerve. Optic atrophy results from the death of the retinal ganglion cell axons that comprise the optic nerve and manifesting as a pale optic nerve on fundoscopy. Evidence: TAS. Frequency: Occasional (HP:0040283). (OMIM:201180)
- Mandibular prognathia (HP:0000303): Abnormal prominence of the chin related to increased length of the mandible. Evidence: TAS. Frequency: Occasional (HP:0040283). (OMIM:201180)
- Brachycephaly (HP:0000248): An abnormality of skull shape characterized by a decreased anterior-posterior diameter. That is, a cephalic index greater than 81%. Alternatively, an apparently shortened anteroposterior dimension (length) of the head compared to width. Evidence: TAS. (OMIM:201180)
- Cleft upper lip (HP:0000204): A gap or groove in the upper lip. This is a congenital defect resulting from nonfusion of tissues of the lip during embryonal development. Evidence: TAS. (OMIM:201180)
These phenotypes are associated with the disease acrofrontofacionasal dysostosis 1 (OMIM:201180).